- Congenital onset (HP:0003577): A phenotypic abnormality that is present at birth. Evidence: PCS. Frequency: 2/2. (PMID:27463701)
- Dysphagia (HP:0002015): Difficulty in swallowing. Evidence: PCS. Frequency: 2/2. (PMID:27463701)
- Microcephaly (HP:0000252): Head circumference below 2 standard deviations below the mean for age and gender. Evidence: PCS. Frequency: 1/2. (PMID:27463701)
- Delayed CNS myelination (HP:0002188): Delayed myelination in the central nervous system. Evidence: PCS. Frequency: 2/3. (PMID:27463701;PMID:27414745)
- Hypoplasia of the corpus callosum (HP:0002079): Underdevelopment of the corpus callosum. Evidence: PCS. Frequency: 1/1. (PMID:27414745)
- Feeding difficulties (HP:0011968): Impaired ability to eat related to problems gathering food and getting ready to suck, chew, or swallow it. Evidence: PCS. Frequency: 2/2. (PMID:27463701)
- Poor suck (HP:0002033): An inadequate sucking reflex, resulting in the difficult of newborns to be breast-fed. Evidence: PCS. Frequency: 1/2. (PMID:27463701)
- Hypotonia (HP:0001252): Hypotonia is an abnormally low muscle tone (the amount of tension or resistance to movement in a muscle). Even when relaxed, muscles have a continuous and passive partial contraction which provides some resistance to passive stretching. Hypotonia thus manifests as diminished resistance to passive stretching. Hypotonia is not the same as muscle weakness, although the two conditions can co-exist. Evidence: PCS. Frequency: 3/3. (PMID:27463701;PMID:27414745)
- Global developmental delay (HP:0001263): A delay in the achievement of motor or mental milestones in the domains of development of a child, including motor skills, speech and language, cognitive skills, and social and emotional skills. This term should only be used to describe children younger than five years of age. Evidence: PCS. Frequency: 2/2. (PMID:27463701)
- Chorea (HP:0002072): Chorea (Greek for 'dance') refers to widespread arrhythmic involuntary movements of a forcible, jerky and restless fashion. It is a random-appearing sequence of one or more discrete involuntary movements or movement fragments. Movements appear random because of variability in timing, duration or location. Each movement may have a distinct start and end. However, movements may be strung together and thus may appear to flow randomly from one muscle group to another. Chorea can involve the trunk, neck, face, tongue, and extremities. Evidence: PCS. Frequency: 1/2. (PMID:27463701)
- Impaired oral bolus formation (HP:0031146): An abnormality of swallowing characterized by reduced tongue coordination to form bolus after chewing. Food material spreads over the oral cavity instead of being concentrated into a bolus that is easily swallowed. Evidence: PCS. Frequency: 1/2. (PMID:27463701)
- Cerebral visual impairment (HP:0100704): A form of loss of vision caused by damage to the visual cortex rather than a defect in the eye. Evidence: PCS. Frequency: 1/2. (PMID:27463701)
- Ptosis (HP:0000508): The upper eyelid margin is positioned 3 mm or more lower than usual and covers the superior portion of the iris (objective); or, the upper lid margin obscures at least part of the pupil (subjective). Evidence: PCS. Frequency: 2/2. (PMID:27463701)
- Progressive leukoencephalopathy (HP:0006980): Leukoencephalopathy that gets more severe with time. Evidence: PCS. Frequency: 1/1. (PMID:27414745)
- Clonic seizure (HP:0020221): A clonic seizure is a type of motor seizure characterized by sustained rhythmic jerking, that is regularly repetitive. Evidence: PCS. Frequency: 1/1. Onset: Neonatal onset (HP:0003623). (PMID:27414745)
- Dandy-Walker malformation (HP:0001305): A congenital brain malformation typically characterized by incomplete formation of the cerebellar vermis, dilation of the fourth ventricle, and enlargement of the posterior fossa. In layman's terms, Dandy Walker malformation is a cyst in the cerebellum (typically symmetrical) that is involved with the fourth ventricle. This may interfere with the ability to drain cerebrospinal fluid from the brain, resulting in hydrocephalus. Dandy Walker cysts are formed during early embryonic development, while the brain forms. The cyst in the cerebellum typically has several blood vessels running through it connecting to the brain, thereby prohibiting surgical removal. Evidence: PCS. Frequency: 1/1. (PMID:27414745)
- Optic disc pallor (HP:0000543): A pale yellow discoloration of the optic disc (the area of the optic nerve head in the retina). The optic disc normally has a pinkish hue with a central yellowish depression. Evidence: PCS. Frequency: 2/2. (PMID:27463701)
- Athetosis (HP:0002305): A slow, continuous, involuntary writhing movement that prevents maintenance of a stable posture. Athetosis involves continuous smooth movements that appear random and are not composed of recognizable sub-movements or movement fragments. In contrast to chorea, in athetosis, the same regions of the body are repeatedly involved. Athetosis may worsen with attempts at movement of posture, but athetosis can also occur at rest. Evidence: PCS. Frequency: 2/2. (PMID:27463701)
- Apnea (HP:0002104): Lack of breathing with no movement of the respiratory muscles and no exchange of air in the lungs. This term refers to a disposition to have recurrent episodes of apnea rather than to a single event. Evidence: PCS. Frequency: 2/2. (PMID:27463701)
- Autosomal dominant inheritance (HP:0000006): A mode of inheritance that is observed for traits related to a gene encoded on one of the autosomes (i.e., the human chromosomes 1-22) in which a trait manifests in heterozygotes. In the context of medical genetics, an autosomal dominant disorder is caused when a single copy of the mutant allele is present. Males and females are affected equally, and can both transmit the disorder with a risk of 50% for each child of inheriting the mutant allele. Evidence: PCS. (PMID:27463701)
- Horizontal nystagmus (HP:0000666): Nystagmus consisting of horizontal to-and-fro eye movements. Evidence: PCS. Frequency: 1/2. (PMID:27463701)
- Myoclonus (HP:0001336): Very brief, involuntary random muscular contractions occurring at rest, in response to sensory stimuli, or accompanying voluntary movements. Evidence: PCS. Frequency: 3/3. (PMID:27463701;PMID:27414745)
- Increased variability in muscle fiber diameter (HP:0003557): An abnormally high degree of muscle fiber size variation. This phenotypic feature can be observed upon muscle biopsy. Evidence: PCS. Frequency: 1/1. (PMID:27463701)
- Neonatal onset (HP:0003623): Onset of signs or symptoms of disease within the first 28 days of life. Evidence: PCS. Frequency: 1/1. (PMID:27414745)
These phenotypes are associated with the disease myoclonus, intractable, neonatal (OMIM:617235).